Phenotypes associated with the disease Brachydactyly type A7 (ORPHA:93397):
- Hallux valgus (HP:0001822): Lateral deviation of the great toe (i.e., in the direction of the little toe). Evidence: TAS. Frequency: Frequent (HP:0040282). (ORPHA:93397)
- Sandal gap (HP:0001852): A widely spaced gap between the first toe (the great toe) and the second toe. Evidence: TAS. Frequency: Frequent (HP:0040282). (ORPHA:93397)
- 2-3 toe syndactyly (HP:0004691): Syndactyly with fusion of toes two and three. Evidence: TAS. Frequency: Frequent (HP:0040282). (ORPHA:93397)
- Aplasia/Hypoplasia of the middle phalanges of the hand (HP:0009843). Evidence: TAS. Frequency: Frequent (HP:0040282). (ORPHA:93397)
- Short hallux (HP:0010109): Underdevelopment (hypoplasia) of the big toe. Evidence: TAS. Frequency: Frequent (HP:0040282). (ORPHA:93397)
- Clinodactyly of the 5th finger (HP:0004209): Clinodactyly refers to a bending or curvature of the fifth finger in the radial direction (i.e., towards the 4th finger). Evidence: TAS. Frequency: Occasional (HP:0040283). (ORPHA:93397)
- Medially deviated second toe (HP:0008096): Medial deviation of the second toe. Evidence: TAS. Frequency: Occasional (HP:0040283). (ORPHA:93397)
- Ulnar deviation of the 2nd finger (HP:0009464): Displacement of the 2nd (index) finger towards the ulnar side. Evidence: TAS. Frequency: Occasional (HP:0040283). (ORPHA:93397)
- Radial deviation of the 2nd finger (HP:0009467): Displacement of the 2nd finger towards the radial side. Evidence: TAS. Frequency: Occasional (HP:0040283). (ORPHA:93397)
- Triangular epiphysis of the middle phalanx of the 2nd finger (HP:0009523). Evidence: TAS. Frequency: Occasional (HP:0040283). (ORPHA:93397)
- Short 2nd finger (HP:0009536): Hypoplasia of the second finger, also known as the index finger. Evidence: TAS. Frequency: Occasional (HP:0040283). (ORPHA:93397)
- Absent middle phalanx of 2nd finger (HP:0009576): Absence of the middle phalanx of the index (2nd) finger. Evidence: TAS. Frequency: Occasional (HP:0040283). (ORPHA:93397)
- Broad distal phalanx of the thumb (HP:0009642): Increased width of the distal phalanx of thumb. Evidence: TAS. Frequency: Occasional (HP:0040283). (ORPHA:93397)
- Finger symphalangism (HP:0009700): An abnormal union between bones or parts of bones of the fingers. The synonymous term "symphalangism of the hand" may be translated as fusions of bones of varying digree, that involve at least one phalangeal bone of the hand. If bony fusions are referred to as "Symphalangism" the fusion occurs in a proximo-distal axis. Fusions of bones of the fingers in a radio-ulnar axis are referred to as "bony" Syndactyly. Evidence: TAS. Frequency: Occasional (HP:0040283). (ORPHA:93397)
- Broad phalanges of the 2nd toe (HP:0010348). Evidence: TAS. Frequency: Occasional (HP:0040283). (ORPHA:93397)
- Broad thumb (HP:0011304): Increased thumb width without increased dorso-ventral dimension. Evidence: TAS. Frequency: Occasional (HP:0040283). (ORPHA:93397)
- Short middle phalanx of the 5th toe (HP:0100394): Developmental hypoplasia of the middle phalanx of the 5th toe. Evidence: TAS. Frequency: Occasional (HP:0040283). (ORPHA:93397)